Phenotypes associated with the disease intellectual developmental disorder with behavioral abnormalities and craniofacial dysmorphism with or without seizures (OMIM:618725):
- Delayed speech and language development (HP:0000750): A degree of language development that is significantly below the norm for a child of a specified age. Evidence: PCS. Frequency: 7/7. (PMID:31649809)
- Seizure (HP:0001250): A seizure is an intermittent abnormality of nervous system physiology characterized by a transient occurrence of signs and/or symptoms due to abnormal excessive or synchronous neuronal activity in the brain. Evidence: PCS. Frequency: 4/7. (PMID:31649809)
- Global developmental delay (HP:0001263): A delay in the achievement of motor or mental milestones in the domains of development of a child, including motor skills, speech and language, cognitive skills, and social and emotional skills. This term should only be used to describe children younger than five years of age. Evidence: IEA. Frequency: 7/7. (PMID:31649809)
- Generalized hypotonia (HP:0001290): Generalized muscular hypotonia (abnormally low muscle tone). Evidence: PCS. Frequency: 3/6. (PMID:31649809)
- Tapered finger (HP:0001182): The gradual reduction in girth of the finger from proximal to distal. Evidence: PCS. Frequency: 3/7. (PMID:31649809)
- Autistic behavior (HP:0000729): Persistent deficits in social interaction and communication and interaction as well as a markedly restricted repertoire of activity and interest as well as repetitive patterns of behavior. Evidence: PCS. Frequency: 3/6. (PMID:31649809)
- Anxiety (HP:0000739): Intense feelings of nervousness, tension, or panic often arise in response to interpersonal stresses. There is worry about the negative effects of past unpleasant experiences and future negative possibilities. Individuals may feel fearful, apprehensive, or threatened by uncertainty, and they may also have fears of falling apart or losing control. Evidence: PCS. Frequency: 4/5. (PMID:31649809)
- Abnormal facial shape (HP:0001999): An abnormal morphology (form) of the face or its components. Evidence: PCS. (PMID:31649809)
- Clinodactyly of the 5th finger (HP:0004209): Clinodactyly refers to a bending or curvature of the fifth finger in the radial direction (i.e., towards the 4th finger). Evidence: PCS. Frequency: 4/7. (PMID:31649809)
- Plagiocephaly (HP:0001357): Asymmetric head shape, which is usually a combination of unilateral occipital flattening with ipsilateral frontal prominence, leading to rhomboid cranial shape. Evidence: PCS. Frequency: 1/7. (PMID:31649809)
- Syndactyly (HP:0001159): Webbing or fusion of the fingers or toes, involving soft parts only or including bone structure. Bony fusions are referred to as "bony" syndactyly if the fusion occurs in a radio-ulnar axis. Fusions of bones of the fingers or toes in a proximo-distal axis are referred to as "symphalangism". Evidence: PCS. Frequency: 2/7. (PMID:31649809)
- Macrocephaly (HP:0000256): Occipitofrontal (head) circumference greater than 97th centile compared to appropriate, age matched, sex-matched normal standards. Alternatively, a apparently increased size of the cranium. Evidence: PCS. Frequency: 2/7. (PMID:31649809)
- Attention deficit hyperactivity disorder (HP:0007018): Attention deficit hyperactivity disorder (ADHD) manifests at age 2-3 years or by first grade at the latest. The main symptoms are distractibility, impulsivity, hyperactivity, and often trouble organizing tasks and projects, difficulty going to sleep, and social problems from being aggressive, loud, or impatient. Evidence: PCS. Frequency: 4/5. (PMID:31649809)
- Autosomal dominant inheritance (HP:0000006): A mode of inheritance that is observed for traits related to a gene encoded on one of the autosomes (i.e., the human chromosomes 1-22) in which a trait manifests in heterozygotes. In the context of medical genetics, an autosomal dominant disorder is caused when a single copy of the mutant allele is present. Males and females are affected equally, and can both transmit the disorder with a risk of 50% for each child of inheriting the mutant allele. Evidence: PCS. (PMID:31649809)
- Intellectual disability (HP:0001249): The term intellectual disability or intellectual developmental disorder is used to describe significantly sub-average intellectual and adaptive functioning based on clinical assessment and as measured by individually administered, appropriately normed, standardized and validated tests of intellectual functioning and adaptive behavior, with onset during the developmental period from infancy through adolescence. Evidence: PCS. Frequency: 7/7. (PMID:31649809)
- Obesity (HP:0001513): Accumulation of substantial excess body fat. Evidence: PCS. Frequency: 4/7. (PMID:31649809)